Phenotypes associated with the disease Rubinstein-Taybi syndrome due to EP300 haploinsufficiency (ORPHA:353284):
- High palate (HP:0000218): Height of the palate more than 2 SD above the mean (objective) or palatal height at the level of the first permanent molar more than twice the height of the teeth (subjective). Evidence: TAS. Frequency: Very frequent (HP:0040281). (ORPHA:353284)
- Facial grimacing (HP:0000273). Evidence: TAS. Frequency: Very frequent (HP:0040281). (ORPHA:353284)
- Hypertelorism (HP:0000316): Interpupillary distance more than 2 SD above the mean (alternatively, the appearance of an increased interpupillary distance or widely spaced eyes). Evidence: TAS. Frequency: Very frequent (HP:0040281). (ORPHA:353284)
- Micrognathia (HP:0000347): Developmental hypoplasia of the mandible. Evidence: TAS. Frequency: Very frequent (HP:0040281). (ORPHA:353284)
- Low-set ears (HP:0000369): Upper insertion of the ear to the scalp below an imaginary horizontal line drawn between the inner canthi of the eye and extending posteriorly to the ear. Evidence: TAS. Frequency: Very frequent (HP:0040281). (ORPHA:353284)
- Downslanted palpebral fissures (HP:0000494): The palpebral fissure inclination is more than two standard deviations below the mean. Evidence: TAS. Frequency: Very frequent (HP:0040281). (ORPHA:353284)
- Delayed speech and language development (HP:0000750): A degree of language development that is significantly below the norm for a child of a specified age. Evidence: TAS. Frequency: Very frequent (HP:0040281). (ORPHA:353284)
- Abnormal facial shape (HP:0001999): An abnormal morphology (form) of the face or its components. Evidence: TAS. Frequency: Very frequent (HP:0040281). (ORPHA:353284)
- Highly arched eyebrow (HP:0002553): Increased height of the central portion of the eyebrow, forming a crescent, semicircular, or inverted U shape. Evidence: TAS. Frequency: Very frequent (HP:0040281). (ORPHA:353284)
- Prominent nasal septum (HP:0005322). Evidence: TAS. Frequency: Very frequent (HP:0040281). (ORPHA:353284)
- Secondary microcephaly (HP:0005484): Head circumference which falls below 2 standard deviations below the mean for age and gender because of insufficient head growth after birth. Evidence: TAS. Frequency: Very frequent (HP:0040281). (ORPHA:353284)
- Widened distal phalanges (HP:0006200). Evidence: TAS. Frequency: Very frequent (HP:0040281). (ORPHA:353284)
- Postnatal growth retardation (HP:0008897): Slow or limited growth after birth. Evidence: TAS. Frequency: Very frequent (HP:0040281). (ORPHA:353284)
- Broad hallux (HP:0010055): Visible increase in width of the hallux without an increase in the dorso-ventral dimension. Evidence: TAS. Frequency: Very frequent (HP:0040281). (ORPHA:353284)
- Broad thumb (HP:0011304): Increased thumb width without increased dorso-ventral dimension. Evidence: TAS. Frequency: Very frequent (HP:0040281). (ORPHA:353284)
- Neurodevelopmental delay (HP:0012758): Neurodevelopmental delay (NDD) refers to delays in the maturation of the brain and central nervous system; infants and young children with NDD may experience delays in the development of one or more skills including gross motor abilities, fine-motor coordination, language abilities and ability to solve increasingly complex problems. Evidence: TAS. Frequency: Very frequent (HP:0040281). (ORPHA:353284)
- Cryptorchidism (HP:0000028): Testis in inguinal canal. That is, absence of one or both testes from the scrotum owing to failure of the testis or testes to descend through the inguinal canal to the scrotum. Evidence: TAS. Frequency: Frequent (HP:0040282). (ORPHA:353284)
- Abnormality of the kidney (HP:0000077): An abnormality of the kidney. Evidence: TAS. Frequency: Frequent (HP:0040282). (ORPHA:353284)
- Abnormality of the genitourinary system (HP:0000119): The presence of any abnormality of the genitourinary system. Evidence: TAS. Frequency: Frequent (HP:0040282). (ORPHA:353284)
- Narrow palate (HP:0000189): Width of the palate more than 2 SD below the mean (objective) or apparently decreased palatal width (subjective). Evidence: TAS. Frequency: Frequent (HP:0040282). (ORPHA:353284)
- Convex nasal ridge (HP:0000444): Nasal ridge curving anteriorly to an imaginary line that connects the nasal root and tip. The nose appears often also prominent, and the columella low. Evidence: TAS. Frequency: Frequent (HP:0040282). (ORPHA:353284)
- Abnormality of the eye (HP:0000478): Any abnormality of the eye, including location, spacing, and intraocular abnormalities. Evidence: TAS. Frequency: Frequent (HP:0040282). (ORPHA:353284)
- Ptosis (HP:0000508): The upper eyelid margin is positioned 3 mm or more lower than usual and covers the superior portion of the iris (objective); or, the upper lid margin obscures at least part of the pupil (subjective). Evidence: TAS. Frequency: Frequent (HP:0040282). (ORPHA:353284)
- Atypical behavior (HP:0000708): Atypical behavior is an abnormality in a person's actions that can be controlled or modulated by the will of the individual. While abnormal behaviors can be difficult to control, they are distinct from other abnormal actions that cannot be affected by the individual's will. Evidence: TAS. Frequency: Frequent (HP:0040282). (ORPHA:353284)
- Emotional lability (HP:0000712): Unstable emotional experiences and frequent mood changes; emotions that are easily aroused, intense, and/or disproportionate to events and circumstances. Evidence: TAS. Frequency: Frequent (HP:0040282). (ORPHA:353284)
- Compulsive behaviors (HP:0000722): Behavior that consists of repetitive acts, characterized by the feeling that one "has to" perform them, while being aware that these acts are not in line with one's overall goal. Evidence: TAS. Frequency: Frequent (HP:0040282). (ORPHA:353284)
- Motor stereotypy (HP:0000733): Use of the same abnormal action in response to certain triggers or at random. They may be used as a way to regulate one's internal state but must otherwise have no apparent functional purpose. Evidence: TAS. Frequency: Frequent (HP:0040282). (ORPHA:353284)
- Agoraphobia (HP:0000756): A type of anxiety disorder characterized by the avoidance of public places, especially where crowds gather. Evidence: TAS. Frequency: Frequent (HP:0040282). (ORPHA:353284)
- Failure to thrive (HP:0001508): Failure to thrive (FTT) refers to a child whose physical growth is substantially below the norm. Evidence: TAS. Frequency: Frequent (HP:0040282). (ORPHA:353284)
- Obesity (HP:0001513): Accumulation of substantial excess body fat. Evidence: TAS. Frequency: Frequent (HP:0040282). (ORPHA:353284)
- Abnormal heart morphology (HP:0001627): Any structural anomaly of the heart. Evidence: TAS. Frequency: Frequent (HP:0040282). (ORPHA:353284)
- Constipation (HP:0002019): Infrequent or difficult evacuation of feces. Evidence: TAS. Frequency: Frequent (HP:0040282). (ORPHA:353284)
- Recurrent respiratory infections (HP:0002205): An increased susceptibility to respiratory infections as manifested by a history of recurrent respiratory infections. Evidence: TAS. Frequency: Frequent (HP:0040282). (ORPHA:353284)
- Obstructive sleep apnea (HP:0002870): Obstructive Sleep Apnea is a condition characterized by the obstruction of the airway and pauses in breathing during sleep, which occur multiple times throughout the night. It is related to the relaxation of muscle tone that typically happens during sleep, leading to a partial collapse of the soft tissues in the airway and causing airflow obstruction. Evidence: TAS. Frequency: Frequent (HP:0040282). (ORPHA:353284)
- Short stature (HP:0004322): A height below that which is expected according to age and gender norms. Although there is no universally accepted definition of short stature, many refer to "short stature" as height more than 2 standard deviations below the mean for age and gender (or below the 3rd percentile for age and gender dependent norms). Evidence: TAS. Frequency: Frequent (HP:0040282). (ORPHA:353284)
- Social and occupational deterioration (HP:0007086). Evidence: TAS. Frequency: Frequent (HP:0040282). (ORPHA:353284)
- Laryngeal cartilage malformation (HP:0008752): A malformation of the laryngeal cartilage. Evidence: TAS. Frequency: Frequent (HP:0040282). (ORPHA:353284)
- Feeding difficulties in infancy (HP:0008872): Impaired feeding performance of an infant as manifested by difficulties such as weak and ineffective sucking, brief bursts of sucking, and falling asleep during sucking. There may be difficulties with chewing or maintaining attention. Evidence: TAS. Frequency: Frequent (HP:0040282). (ORPHA:353284)
- Low hanging columella (HP:0009765): Columella extending inferior to the level of the nasal base, when viewed from the side. Evidence: TAS. Frequency: Frequent (HP:0040282). (ORPHA:353284)
- Abnormal proximal phalanx morphology of the hand (HP:0009834). Evidence: TAS. Frequency: Frequent (HP:0040282). (ORPHA:353284)
- Broad distal phalanx of finger (HP:0009836): Abnormally wide (broad) distal phalanx of finger. Evidence: TAS. Frequency: Frequent (HP:0040282). (ORPHA:353284)
- Talon cusp (HP:0011087): Talon cusp is an accessory cusp located near the cingulum (the portion of the lingual or palatal aspect of the tooth that forms a convex protuberance at the cervical third of the anatomic crown). Evidence: TAS. Frequency: Frequent (HP:0040282). (ORPHA:353284)
- Reduced social responsiveness (HP:0012760): A reduced ability to participate in the back-and-forth flow of social interaction appropriate to culture and developmental level, which is normally characterized by an influence of the behavior of one person on the behavior of another person. This results in difficulty interacting with others through emotional, physical, or verbal communication. Evidence: TAS. Frequency: Frequent (HP:0040282). (ORPHA:353284)
- Panic attack (HP:0025269): A sudden episode of intense fear in a situation where there is no danger or apparent cause. Evidence: TAS. Frequency: Frequent (HP:0040282). (ORPHA:353284)
- Abnormal cardiovascular system morphology (HP:0030680): Any structural anomaly of the heart and blood vessels. Evidence: TAS. Frequency: Frequent (HP:0040282). (ORPHA:353284)
- Impulsivity (HP:0100710): Acting on the spur of the moment or on a momentary basis without consideration of outcomes; having difficulty establishing or following plans; experiencing a sense of urgency and engaging in behavior that is uninhibited, cannot be inhibited, and is uncontrolled. The possibility of repression is inconceivable. Evidence: TAS. Frequency: Frequent (HP:0040282). (ORPHA:353284)
- Abnormal fear-induced behavior (HP:0100852): An abnormal fear-induced behavior includes observable actions. This behavior is characterized by abnormal responses to fear or abnormal fear levels. Examples of such behavior include avoiding fear-inducing situations. Evidence: TAS. Frequency: Frequent (HP:0040282). (ORPHA:353284)
- Brain imaging abnormality (HP:0410263): An anomaly of metabolism or structure of the brain identified by imaging. Evidence: TAS. Frequency: Frequent (HP:0040282). (ORPHA:353284)
- Recurrent urinary tract infections (HP:0000010): Repeated infections of the urinary tract. Evidence: TAS. Frequency: Occasional (HP:0040283). (ORPHA:353284)
- Hydrocele testis (HP:0000034): Accumulation of clear fluid in the between the layers of membrane (tunica vaginalis) surrounding the testis. Evidence: TAS. Frequency: Occasional (HP:0040283). (ORPHA:353284)
- Hypospadias (HP:0000047): Abnormal position of urethral meatus on the ventral penile shaft (underside) characterized by displacement of the urethral meatus from the tip of the glans penis to the ventral surface of the penis, scrotum, or perineum. Evidence: TAS. Frequency: Occasional (HP:0040283). (ORPHA:353284)
- Vesicoureteral reflux (HP:0000076): Abnormal (retrograde) movement of urine from the bladder into ureters or kidneys related to inadequacy of the valvular mechanism at the ureterovesicular junction or other causes. Evidence: TAS. Frequency: Occasional (HP:0040283). (ORPHA:353284)
- Abnormality of the urinary system (HP:0000079): An abnormality of the urinary system. Evidence: TAS. Frequency: Occasional (HP:0040283). (ORPHA:353284)
- Hydronephrosis (HP:0000126): Severe distention of the kidney with dilation of the renal pelvis and calices. Evidence: TAS. Frequency: Occasional (HP:0040283). (ORPHA:353284)
- Otitis media (HP:0000388): Inflammation or infection of the middle ear. Evidence: TAS. Frequency: Occasional (HP:0040283). (ORPHA:353284)
- Conductive hearing impairment (HP:0000405): An abnormality of vibrational conductance of sound to the inner ear leading to impairment of sensory perception of sound. Evidence: TAS. Frequency: Occasional (HP:0040283). (ORPHA:353284)
- Strabismus (HP:0000486): A misalignment of the eyes so that the visual axes deviate from bifoveal fixation. The classification of strabismus may be based on a number of features including the relative position of the eyes, whether the deviation is latent or manifest, intermittent or constant, concomitant or otherwise and according to the age of onset and the relevance of any associated refractive error. Evidence: TAS. Frequency: Occasional (HP:0040283). (ORPHA:353284)
- Glaucoma (HP:0000501): Glaucoma refers loss of retinal ganglion cells in a characteristic pattern of optic neuropathy usually associated with increased intraocular pressure. Evidence: TAS. Frequency: Occasional (HP:0040283). (ORPHA:353284)
- Hypermetropia (HP:0000540): An abnormality of refraction characterized by the ability to see objects in the distance clearly, while objects nearby appear blurry. Evidence: TAS. Frequency: Occasional (HP:0040283). (ORPHA:353284)
- Corneal scarring (HP:0000559). Evidence: TAS. Frequency: Occasional (HP:0040283). (ORPHA:353284)
- Nasolacrimal duct obstruction (HP:0000579): Blockage of the lacrimal duct. Evidence: TAS. Frequency: Occasional (HP:0040283). (ORPHA:353284)
- Nystagmus (HP:0000639): Rhythmic, involuntary oscillations of one or both eyes related to abnormality in fixation, conjugate gaze, or vestibular mechanisms. Evidence: TAS. Frequency: Occasional (HP:0040283). (ORPHA:353284)
- Hypodontia (HP:0000668): The absence of five or less teeth from the normal series by a failure to develop. Evidence: TAS. Frequency: Occasional (HP:0040283). (ORPHA:353284)
- Carious teeth (HP:0000670): Caries is a multifactorial bacterial infection affecting the structure of the tooth. This term has been used to describe the presence of more than expected dental caries. Evidence: TAS. Frequency: Occasional (HP:0040283). (ORPHA:353284)
- Dental crowding (HP:0000678): Changes in alignment of teeth in the dental arch. Evidence: TAS. Frequency: Occasional (HP:0040283). (ORPHA:353284)
- Dental malocclusion (HP:0000689): Dental malocclusion refers to an abnormality of the occlusion, or alignment, of the teeth and the way the upper and lower teeth fit together, resulting in overcrowding of teeth or in abnormal bite patterns. Evidence: TAS. Frequency: Occasional (HP:0040283). (ORPHA:353284)
- Aggressive behavior (HP:0000718): Behavior or an act aimed at harming a person, animal, or physical property (e.g., acts of physical violence; shouting, swearing, and using harsh language; slashing someone's tires). Evidence: TAS. Frequency: Occasional (HP:0040283). (ORPHA:353284)
- Hyperactivity (HP:0000752): Hyperactivity is a condition characterized by constant and unusually high levels of activity, even in situations where it is deemed inappropriate. Evidence: TAS. Frequency: Occasional (HP:0040283). (ORPHA:353284)
- Kidney stone (HP:0000787): Kidney stones (calculi) are mineral concretions in the renal calyces and pelvis that are found free or attached to the renal papillae. Evidence: TAS. Frequency: Occasional (HP:0040283). (ORPHA:353284)
- Abnormal posterior cranial fossa morphology (HP:0000932): An abnormality of the fossa cranii posterior (the posterior fossa), which is made up primarily of the occipital bone and which surrounds to the foramen magnum. Evidence: TAS. Frequency: Occasional (HP:0040283). (ORPHA:353284)
- Trichiasis (HP:0001128): Inversion and rubbing of the eyelashes against the globe of the eye. Evidence: TAS. Frequency: Occasional (HP:0040283). (ORPHA:353284)
- Syndactyly (HP:0001159): Webbing or fusion of the fingers or toes, involving soft parts only or including bone structure. Bony fusions are referred to as "bony" syndactyly if the fusion occurs in a radio-ulnar axis. Fusions of bones of the fingers or toes in a proximo-distal axis are referred to as "symphalangism". Evidence: TAS. Frequency: Occasional (HP:0040283). (ORPHA:353284)
- Intellectual disability (HP:0001249): The term intellectual disability or intellectual developmental disorder is used to describe significantly sub-average intellectual and adaptive functioning based on clinical assessment and as measured by individually administered, appropriately normed, standardized and validated tests of intellectual functioning and adaptive behavior, with onset during the developmental period from infancy through adolescence. Evidence: TAS. Frequency: Occasional (HP:0040283). (ORPHA:353284)
- Hypotonia (HP:0001252): Hypotonia is an abnormally low muscle tone (the amount of tension or resistance to movement in a muscle). Even when relaxed, muscles have a continuous and passive partial contraction which provides some resistance to passive stretching. Hypotonia thus manifests as diminished resistance to passive stretching. Hypotonia is not the same as muscle weakness, although the two conditions can co-exist. Evidence: TAS. Frequency: Occasional (HP:0040283). (ORPHA:353284)
- Abnormal corpus callosum morphology (HP:0001273): Abnormality of the corpus callosum. Evidence: TAS. Frequency: Occasional (HP:0040283). (ORPHA:353284)
- Absent speech (HP:0001344): Complete lack of development of speech and language abilities. Evidence: TAS. Frequency: Occasional (HP:0040283). (ORPHA:353284)
- Joint hypermobility (HP:0001382): The capability that a joint (or a group of joints) has to move, passively and/or actively, beyond normal limits along physiological axes. Evidence: TAS. Frequency: Occasional (HP:0040283). (ORPHA:353284)
- Hip dysplasia (HP:0001385): The presence of developmental dysplasia of the hip. Evidence: TAS. Frequency: Occasional (HP:0040283). (ORPHA:353284)
- Intrauterine growth retardation (HP:0001511): An abnormal restriction of fetal growth with fetal weight below the tenth percentile for gestational age. Evidence: TAS. Frequency: Occasional (HP:0040283). (ORPHA:353284)
- Polyhydramnios (HP:0001561): The presence of excess amniotic fluid in the uterus during pregnancy. Evidence: TAS. Frequency: Occasional (HP:0040283). (ORPHA:353284)
- Ventricular septal defect (HP:0001629): A hole between the two bottom chambers (ventricles) of the heart. The defect is centered around the most superior aspect of the ventricular septum. Evidence: TAS. Frequency: Occasional (HP:0040283). (ORPHA:353284)
- Atrial septal defect (HP:0001631): Atrial septal defect (ASD) is a congenital abnormality of the interatrial septum that enables blood flow between the left and right atria via the interatrial septum. Evidence: TAS. Frequency: Occasional (HP:0040283). (ORPHA:353284)
- Patent ductus arteriosus (HP:0001643): In utero, the ductus arteriosus (DA) serves to divert ventricular output away from the lungs and toward the placenta by connecting the main pulmonary artery to the descending aorta. A patent ductus arteriosus (PDA) in the first 3 days of life is a physiologic shunt in healthy term and preterm newborn infants, and normally is substantially closed within about 24 hours after bith and completely closed after about three weeks. Failure of physiologcal closure is referred to a persistent or patent ductus arteriosus (PDA). Depending on the degree of left-to-right shunting, PDA can have clinical consequences. Evidence: TAS. Frequency: Occasional (HP:0040283). (ORPHA:353284)
- Patent foramen ovale (HP:0001655): Failure of the foramen ovale to seal postnatally, leaving a potential conduit between the left and right cardiac atria. Evidence: TAS. Frequency: Occasional (HP:0040283). (ORPHA:353284)
- Gastroesophageal reflux (HP:0002020): A condition in which the stomach contents leak backwards from the stomach into the esophagus through the lower esophageal sphincter. Evidence: TAS. Frequency: Occasional (HP:0040283). (ORPHA:353284)
- Pneumonia (HP:0002090): Inflammation of any part of the lung parenchyma. Evidence: TAS. Frequency: Occasional (HP:0040283). (ORPHA:353284)
- Chiari malformation (HP:0002308): Chiari malformation consists of a downward displacement of the cerebellar tonsils and the medulla through the foramen magnum, sometimes causing hydrocephalus as a result of obstruction of CSF outflow. Evidence: TAS. Frequency: Occasional (HP:0040283). (ORPHA:353284)
- Aspiration (HP:0002835): Inspiration of a foreign object into the airway. Evidence: TAS. Frequency: Occasional (HP:0040283). (ORPHA:353284)
- Meningioma (HP:0002858): The presence of a meningioma, i.e., a benign tumor originating from the dura mater or arachnoid mater. Evidence: TAS. Frequency: Occasional (HP:0040283). (ORPHA:353284)
- Patellar dislocation (HP:0002999): The kneecap normally is located within the groove termed trochlea on the distal femur and can slide up and down in it. Patellar dislocation occurs if the patella fully dislocates out of the groove. Evidence: TAS. Frequency: Occasional (HP:0040283). (ORPHA:353284)
- Abnormality of the cervical spine (HP:0003319): Any abnormality of the cervical vertebral column. Evidence: TAS. Frequency: Occasional (HP:0040283). (ORPHA:353284)
- Avascular necrosis of the capital femoral epiphysis (HP:0005743): Avascular necrosis of the proximal epiphysis of the femur occurring in growing children and caused by an interruption of the blood supply to the head of the femur close to the hip joint. The necrosis is characteristically associated with flattening of the femoral head, for which reason the term coxa plana has been used to refer to this feature in the medical literature. Evidence: TAS. Frequency: Occasional (HP:0040283). (ORPHA:353284)
- Chiari type I malformation (HP:0007099): Arnold-Chiari type I malformation refers to a relatively mild degree of herniation of the posteroinferior region of the cerebellum (the cerebellar tonsils) into the cervical canal with little or no displacement of the fourth ventricle. It is characterized by one or both pointed (not rounded) cerebellar tonsils that project 5 mm below the foramen magnum, measured by a line drawn from the basion to the opisthion (McRae Line). Evidence: TAS. Frequency: Occasional (HP:0040283). (ORPHA:353284)
- Deviation of the hallux (HP:0010051): Displacement of the big toe from its normal position. Evidence: TAS. Frequency: Occasional (HP:0040283). (ORPHA:353284)
- Polydactyly (HP:0010442): A congenital anomaly characterized by the presence of supernumerary fingers or toes. Evidence: TAS. Frequency: Occasional (HP:0040283). (ORPHA:353284)
- Abnormal curvature of the vertebral column (HP:0010674): The presence of an abnormal curvature of the vertebral column. Evidence: TAS. Frequency: Occasional (HP:0040283). (ORPHA:353284)
- Supernumerary tooth (HP:0011069): The presence of one or more teeth additional to the normal number. Evidence: TAS. Frequency: Occasional (HP:0040283). (ORPHA:353284)
- Nasogastric tube feeding in infancy (HP:0011470): Feeding problem necessitating nasogastric tube feeding. Evidence: TAS. Frequency: Occasional (HP:0040283). (ORPHA:353284)
- Delayed myelination (HP:0012448): Delayed myelination. Evidence: TAS. Frequency: Occasional (HP:0040283). (ORPHA:353284)
- Abnormal lateral ventricle morphology (HP:0030047): A morphological anomaly of the lateral ventricle. Evidence: TAS. Frequency: Occasional (HP:0040283). (ORPHA:353284)
- Abnormal subclavian artery morphology (HP:0031251): Any anomaly of a subclavian artery. Evidence: TAS. Frequency: Occasional (HP:0040283). (ORPHA:353284)
- Cardiac conduction abnormality (HP:0031546): Any anomaly of the progression of electrical impulses through the heart. Evidence: TAS. Frequency: Occasional (HP:0040283). (ORPHA:353284)
- Self-injurious behavior (HP:0100716): Self-aggression. Evidence: TAS. Frequency: Occasional (HP:0040283). (ORPHA:353284)
- Sensorineural hearing impairment (HP:0000407): A type of hearing impairment in one or both ears related to an abnormal functionality of the cochlear nerve. Evidence: TAS. Frequency: Very rare (HP:0040284). (ORPHA:353284)
- Cataract (HP:0000518): A cataract is an opacity or clouding that develops in the crystalline lens of the eye or in its capsule. Evidence: TAS. Frequency: Very rare (HP:0040284). (ORPHA:353284)
- Coloboma (HP:0000589): A developmental defect characterized by a cleft of some portion of the eye or ocular adnexa. Evidence: TAS. Frequency: Very rare (HP:0040284). (ORPHA:353284)
- Natal tooth (HP:0000695): A tooth present at birth or erupting within the first month of life. Evidence: TAS. Frequency: Very rare (HP:0040284). (ORPHA:353284)
- Adducted thumb (HP:0001181): In the resting position, the tip of the thumb is on, or near, the palm, close to the base of the fourth or fifth finger. Evidence: TAS. Frequency: Very rare (HP:0040284). (ORPHA:353284)
- Seizure (HP:0001250): A seizure is an intermittent abnormality of nervous system physiology characterized by a transient occurrence of signs and/or symptoms due to abnormal excessive or synchronous neuronal activity in the brain. Evidence: TAS. Frequency: Very rare (HP:0040284). (ORPHA:353284)
- Pulmonic stenosis (HP:0001642): A narrowing of the right ventricular outflow tract that can occur at the pulmonary valve (valvular stenosis), below the pulmonary valve (infundibular stenosis), or above the pulmonary valve (supravalvar stenosis). Evidence: TAS. Frequency: Very rare (HP:0040284). (ORPHA:353284)
- Bicuspid aortic valve (HP:0001647): The presence of an aortic valve with two instead of the normal three cusps (flaps). Bicuspid aortic valvue is a malformation of a commissure (small space between the attachment of each cusp to the aortic wall) and the adjacent parts of the two corresponding cusps forming a raphe (the fused area of the two underdeveloped cusps turning into a malformed commissure between both cusps; the raphe is a fibrous ridge that extends from the commissure to the free edge of the two underdeveloped, conjoint cusps). Evidence: TAS. Frequency: Very rare (HP:0040284). (ORPHA:353284)
- Aortic valve stenosis (HP:0001650): The presence of a stenosis (narrowing) of the aortic valve. Evidence: TAS. Frequency: Very rare (HP:0040284). (ORPHA:353284)
- Coarctation of aorta (HP:0001680): Coarctation of the aorta is a narrowing or constriction of a segment of the aorta. Evidence: TAS. Frequency: Very rare (HP:0040284). (ORPHA:353284)
- Asthma (HP:0002099): Asthma is characterized by increased responsiveness of the tracheobronchial tree to multiple stimuli, leading to narrowing of the air passages with resultant dyspnea, cough, and wheezing. Evidence: TAS. Frequency: Very rare (HP:0040284). (ORPHA:353284)
- Cervical cord compression (HP:0002341): Compression of the spinal cord in the cervical region, generally manifested by paresthesias and numbness, weakness, difficulty walking, abnormalities of coordination, and neck pain or stiffness. Evidence: TAS. Frequency: Very rare (HP:0040284). (ORPHA:353284)
- EEG abnormality (HP:0002353): Abnormality observed by electroencephalogram (EEG), which is used to record of the brain's spontaneous electrical activity from multiple electrodes placed on the scalp. Evidence: TAS. Frequency: Very rare (HP:0040284). (ORPHA:353284)
- Intestinal malrotation (HP:0002566): An abnormality of the intestinal rotation and fixation that normally occurs during the development of the gut. This can lead to volvulus, or twisting of the intestine that causes obstruction and necrosis. Evidence: TAS. Frequency: Very rare (HP:0040284). (ORPHA:353284)
- Syringomyelia (HP:0003396): Dilated, glial-lined cavity in spinal cord. This cavity does not communicate with the central canal, and usually is between the dorsal columns unilaterally or bilaterally along the side of the cord. Evidence: TAS. Frequency: Very rare (HP:0040284). (ORPHA:353284)
- Humoral immunodeficiency (HP:0005363): A general term referring to a defect in immunity resulting from impaired antibody production. Evidence: TAS. Frequency: Very rare (HP:0040284). (ORPHA:353284)
- Cellular immunodeficiency (HP:0005374): An immunodeficiency characterized by defective cell-mediated immunity or humoral immunity. Evidence: TAS. Frequency: Very rare (HP:0040284). (ORPHA:353284)
- Keloids (HP:0010562). Evidence: TAS. Frequency: Very rare (HP:0040284). (ORPHA:353284)
- Vascular ring (HP:0010775): A developmental defect of the aortic arch system in which the trachea and esophagus are completely encircled by connected segments of the aortic arch and its branches. This occurs if the normal process of regression and persistence of the bilateral embryonic aortic arches fails. Evidence: TAS. Frequency: Very rare (HP:0040284). (ORPHA:353284)
- Pilomatrixoma (HP:0030434): Pilomatricoma is an asymptomatic slowly growing benign cutaneous tumor, differentiating towards the hair matrix of the hair follicle. It is covered by normal or hyperemic skin, and usually varies in size from 0.5 to 3 cm. Evidence: TAS. Frequency: Very rare (HP:0040284). (ORPHA:353284)